- Hypertension (HP:0000822): The presence of chronic increased pressure in the systemic arterial system. Evidence: TAS. Frequency: Obligate (HP:0040280). (ORPHA:403)
- Dexamethasone-suppressible primary hyperaldosteronism (HP:0011739): A form of primary hyperaldosteronism in which the overproduction of aldosterone can be suppressed by the administration of dexamethasone. Evidence: TAS. Frequency: Obligate (HP:0040280). (ORPHA:403)
- Adrenal hyperplasia (HP:0008221): Enlargement of the adrenal gland. Evidence: TAS. Frequency: Very frequent (HP:0040281). (ORPHA:403)
- Abnormal circulating renin concentration (HP:0040084): A deviation from the normal concentration of renin in the blood, a central hormone in the control of blood pressure and various other physiological functions. Evidence: TAS. Frequency: Very frequent (HP:0040281). (ORPHA:403)
- Tinnitus (HP:0000360): Tinnitus is an auditory perception that can be described as the experience of sound, in the ear or in the head, in the absence of external acoustic stimulation. Evidence: TAS. Frequency: Occasional (HP:0040283). (ORPHA:403)
- Epistaxis (HP:0000421): Epistaxis, or nosebleed, refers to a hemorrhage localized in the nose. Evidence: TAS. Frequency: Occasional (HP:0040283). (ORPHA:403)
- Muscle weakness (HP:0001324): Reduced strength of muscles. Evidence: TAS. Frequency: Occasional (HP:0040283). (ORPHA:403)
- Polydipsia (HP:0001959): Excessive thirst manifested by excessive fluid intake. Evidence: TAS. Frequency: Occasional (HP:0040283). (ORPHA:403)
- Nausea (HP:0002018): A sensation of unease in the stomach together with an urge to vomit. Evidence: TAS. Frequency: Occasional (HP:0040283). (ORPHA:403)
- Intracranial hemorrhage (HP:0002170): Hemorrhage occurring within the skull. Evidence: TAS. Frequency: Occasional (HP:0040283). (ORPHA:403)
- Headache (HP:0002315): Cephalgia, or pain sensed in various parts of the head, not confined to the area of distribution of any nerve. Evidence: TAS. Frequency: Occasional (HP:0040283). (ORPHA:403)
- Hypokalemia (HP:0002900): The concentration of potassium(1+) in the blood circulation is below the lower limit of normal. Evidence: TAS. Frequency: Occasional (HP:0040283). (ORPHA:403)
- Caesarean section (HP:0011410): Delivery of a fetus through surgical incisions made through the abdominal wall (laparotomy) and the uterine wall (hysterotomy). Evidence: TAS. Frequency: Occasional (HP:0040283). (ORPHA:403)
- Secretory adrenocortical adenoma (HP:0011746): An hormonally active adrenocortical adenoma, that is, an adenoma that secretes excessive amounts of adrenal hormones. Evidence: TAS. Frequency: Occasional (HP:0040283). (ORPHA:403)
- Preeclampsia (HP:0100602): Pregnancy-induced hypertension in association with significant amounts of protein in the urine. Evidence: TAS. Frequency: Occasional (HP:0040283). (ORPHA:403)
These phenotypes are associated with the disease Familial hyperaldosteronism type I (ORPHA:403).